Phenotypes associated with the disease primary ciliary dyskinesia 24 (OMIM:615481):
- Ciliary dyskinesia (HP:0012265): A deviation from the normally well coordinated pattern of intracellular and intercellular synchrony of motile cilia. Dyskinetic cilia usually beat out of synchrony relative to neighboring cilia. Evidence: PCS. (PMID:23993197)
- Chronic rhinitis (HP:0002257): Chronic inflammation of the nasal mucosa. Evidence: PCS. Frequency: 10/12. (PMID:23993197)
- Situs inversus totalis (HP:0001696): A left-right reversal (or mirror reflection) of the anatomical location of the major thoracic and abdominal organs. Evidence: PCS. Frequency: 0/12. (PMID:23993197)
- Bronchiectasis (HP:0002110): Persistent abnormal dilatation of the bronchi owing to localized and irreversible destruction and widening of the large airways. Evidence: PCS. Frequency: 9/12. (PMID:23993197)
- Immotile cilia (HP:0012263). Evidence: PCS. Frequency: 1/12. (PMID:23993197)
- Infertility (HP:0000789). Evidence: PCS. Frequency: 4/4. (PMID:23993197)
- Decreased nasal nitric oxide (HP:0033036): Reduced level of nasal nitric oxide (nNO). Current American Thoracic Society/European Respiratory Society (ATS/ERS) guidelines for nNO measurements recommend air aspiration via a nasal probe while the subject exhales through the mouth against resistance in order to maintain velum closure. Evidence: PCS. Frequency: 4/5. (PMID:23993197)
- Autosomal recessive inheritance (HP:0000007): A mode of inheritance that is observed for traits related to a gene encoded on one of the autosomes (i.e., the human chromosomes 1-22) in which a trait manifests in individuals with two pathogenic alleles, either homozygotes (two copies of the same mutant allele) or compound heterozygotes (whereby each copy of a gene has a distinct mutant allele). Evidence: PCS. (PMID:23993197)
- Recurrent otitis media (HP:0000403): Increased susceptibility to otitis media, as manifested by recurrent episodes of otitis media. Evidence: PCS. Frequency: 8/12. (PMID:23993197)
- Chronic pulmonary obstruction (HP:0006510): An anomaly that is characterized progressive airflow obstruction that is only partly reversible, inflammation in the airways, and systemic effects or comorbities. Evidence: PCS. Frequency: 3/12. (PMID:23993197)
- Recurrent sinusitis (HP:0011108): A recurrent form of sinusitis. Evidence: PCS. Frequency: 10/12. (PMID:23993197)
- Neonatal respiratory distress (HP:0002643): Respiratory difficulty as newborn. Evidence: PCS. Frequency: 4/12. Onset: Neonatal onset (HP:0003623). (PMID:23993197)